Phenotypes associated with the disease Hereditary gingival fibromatosis (ORPHA:2024):
- Gingival fibromatosis (HP:0000169): The presence of fibrosis of the gingiva. Evidence: TAS. Frequency: Very frequent (HP:0040281). (ORPHA:2024)
- Gingival overgrowth (HP:0000212): Hyperplasia of the gingiva (that is, a thickening of the soft tissue overlying the alveolar ridge. The degree of thickening ranges from involvement of the interdental papillae alone to gingival overgrowth covering the entire tooth crown. Evidence: TAS. Frequency: Very frequent (HP:0040281). (ORPHA:2024)